- Typified by incomplete penetrance (HP:0003829): Description of conditions in which not all individuals with a given genotype exhibit the disease. Penetrance is the proportion that develop disease given a lifespan of 80 years. Evidence: IEA. (OMIM:173600)
- Spontaneous pneumothorax (HP:0002108): Pneumothorax occurring without traumatic injury to the chest or lung. Evidence: TAS. (OMIM:173600)
- Autosomal dominant inheritance (HP:0000006): A mode of inheritance that is observed for traits related to a gene encoded on one of the autosomes (i.e., the human chromosomes 1-22) in which a trait manifests in heterozygotes. In the context of medical genetics, an autosomal dominant disorder is caused when a single copy of the mutant allele is present. Males and females are affected equally, and can both transmit the disorder with a risk of 50% for each child of inheriting the mutant allele. Evidence: IEA. (OMIM:173600)
These phenotypes are associated with the disease familial spontaneous pneumothorax (OMIM:173600).